- Typified by somatic mosaicism (HP:0001442): Description of conditions in which affected individuals typically display somatic mosaicism, i.e., genetically distinct populations of somatic cells in a given organism caused by DNA mutations, epigenetic alterations of DNA, chromosomal abnormalities or the spontaneous reversion of inherited mutations. In many conditions typified by somatic mosaicism, constitutive mutation is lethal and cases are exclusively or predominantly mosaic. Evidence: TAS. (OMIM:606960)
- Insulinoma (HP:0012197): A type of tumor of the pancreatic beta cells that secretes excess insulin and can result in hypoglycemia. Evidence: TAS. (OMIM:606960)
These phenotypes are associated with the disease Insulinoma tumor suppressor gene locus (OMIM:606960).